- Insidious onset (HP:0003587): Gradual, very slow onset of disease manifestations. Evidence: PCS. (PMID:21907011)
- Resting tremor (HP:0002322): A resting tremor occurs when muscles are at rest and becomes less noticeable or disappears when the affected muscles are moved. Resting tremors are often slow and coarse. Evidence: PCS. (PMID:21907011)
- Lewy bodies (HP:0100315). Evidence: PCS. (PMID:21907011)
- Bradykinesia (HP:0002067): Bradykinesia literally means slow movement, and is used clinically to denote a slowness in the execution of movement (in contrast to hypokinesia, which is used to refer to slowness in the initiation of movement). Evidence: PCS. (PMID:21907011)
- Parkinsonism (HP:0001300): Characteristic neurologic anomaly resulting from degeneration of dopamine-generating cells in the substantia nigra, a region of the midbrain, characterized clinically by shaking, rigidity, slowness of movement and difficulty with walking and gait. Evidence: PCS. (PMID:21907011)
- Middle age onset (HP:0003596): A type of adult onset with onset of symptoms at the age of 40 to 60 years. Evidence: PCS. (PMID:21907011)
- Late onset (HP:0003584): A type of adult onset with onset of symptoms after the age of 60 years. Evidence: PCS. (PMID:21907011)
- Rigidity (HP:0002063): Continuous involuntary sustained muscle contraction. When an affected muscle is passively stretched, the degree of resistance remains constant regardless of the rate at which the muscle is stretched. This feature helps to distinguish rigidity from muscle spasticity. Evidence: PCS. (PMID:21907011)
- Autosomal dominant inheritance (HP:0000006): A mode of inheritance that is observed for traits related to a gene encoded on one of the autosomes (i.e., the human chromosomes 1-22) in which a trait manifests in heterozygotes. In the context of medical genetics, an autosomal dominant disorder is caused when a single copy of the mutant allele is present. Males and females are affected equally, and can both transmit the disorder with a risk of 50% for each child of inheriting the mutant allele. Evidence: PCS. (PMID:21907011)
These phenotypes are associated with the disease Parkinson disease 18, autosomal dominant, susceptibility to (OMIM:614251).